- Thrombocytopenia (HP:0001873): A reduction in the number of circulating thrombocytes. Evidence: TAS. Frequency: Frequent (HP:0040282). (ORPHA:509)
- Fever (HP:0001945): Body temperature elevated above the normal range. Evidence: TAS. Frequency: Frequent (HP:0040282). (ORPHA:509)
- Nausea and vomiting (HP:0002017): Nausea is a commonly encountered symptom that has been defined as an unpleasant painless subjective feeling that one will imminently vomit. Vomiting has been defined as the forceful expulsion of the contents of the stomach, duodenum, or jejunum through the oral cavity. While nausea and vomiting are often thought to exist on a temporal continuum, this is not always the case. There are situations when severe nausea may be present without emesis and less frequently, when emesis may be present without preceding nausea. Evidence: TAS. Frequency: Frequent (HP:0040282). (ORPHA:509)
- Abdominal pain (HP:0002027): An unpleasant sensation characterized by physical discomfort (such as pricking, throbbing, or aching) and perceived to originate in the abdomen. Evidence: TAS. Frequency: Frequent (HP:0040282). (ORPHA:509)
- Anorexia (HP:0002039): Lack of desire to eat (loss of appetite). Evidence: TAS. Frequency: Frequent (HP:0040282). (ORPHA:509)
- Hyperproteinemia (HP:0002152): An increased concentration of proteins in the blood. Evidence: TAS. Frequency: Frequent (HP:0040282). (ORPHA:509)
- Headache (HP:0002315): Cephalgia, or pain sensed in various parts of the head, not confined to the area of distribution of any nerve. Evidence: TAS. Frequency: Frequent (HP:0040282). (ORPHA:509)
- Hypotension (HP:0002615): Low Blood Pressure, vascular hypotension. Evidence: TAS. Frequency: Frequent (HP:0040282). (ORPHA:509)
- Arthralgia (HP:0002829): Joint pain. Evidence: TAS. Frequency: Frequent (HP:0040282). (ORPHA:509)
- Myalgia (HP:0003326): Pain in muscle. Evidence: TAS. Frequency: Frequent (HP:0040282). (ORPHA:509)
- Elevated serum transaminases during infections (HP:0008150): Elevations of the levels of SGOT (serum glutamic oxaloacetic transaminase) and SGPT (serum glutamic pyruvic transaminase) that occur during infections. Evidence: TAS. Frequency: Frequent (HP:0040282). (ORPHA:509)
- Conjunctival hyperemia (HP:0030953): Dilatation of the blood vessels of the conjunctiva leading to a red appearance of the sclera. Evidence: TAS. Frequency: Frequent (HP:0040282). (ORPHA:509)
- Jaundice (HP:0000952): Yellow pigmentation of the skin due to bilirubin, which in turn is the result of increased bilirubin concentration in the bloodstream. Evidence: TAS. Frequency: Occasional (HP:0040283). (ORPHA:509)
- Skin rash (HP:0000988): A red eruption of the skin. Evidence: TAS. Frequency: Occasional (HP:0040283). (ORPHA:509)
- Meningitis (HP:0001287): Inflammation of the meninges. Evidence: TAS. Frequency: Occasional (HP:0040283). (ORPHA:509)
- Acute kidney injury (HP:0001919): Sudden loss of renal function, as manifested by decreased urine production, and a rise in serum creatinine or blood urea nitrogen concentration (azotemia). Evidence: TAS. Frequency: Occasional (HP:0040283). (ORPHA:509)
- Morphological central nervous system abnormality (HP:0002011): A structural abnormality of the central nervous system. Evidence: TAS. Frequency: Occasional (HP:0040283). (ORPHA:509)
- Diarrhea (HP:0002014): Abnormally increased frequency (usually defined as three or more) loose or watery bowel movements a day. Evidence: TAS. Frequency: Occasional (HP:0040283). (ORPHA:509)
- Respiratory distress (HP:0002098): Respiratory distress is objectively observable as the physical or emotional consequences from the experience of dyspnea. The physical presentation of respiratory distress is generally referred to as labored breathing, while the sensation of respiratory distress is called shortness of breath or dyspnea. Evidence: TAS. Frequency: Occasional (HP:0040283). (ORPHA:509)
- Hemoptysis (HP:0002105): Coughing up (expectoration) of blood or blood-streaked sputum from the larynx, trachea, bronchi, or lungs. Evidence: TAS. Frequency: Occasional (HP:0040283). (ORPHA:509)
- Pleural effusion (HP:0002202): The presence of an excessive amount of fluid in the pleural cavity. Evidence: TAS. Frequency: Occasional (HP:0040283). (ORPHA:509)
- Hepatomegaly (HP:0002240): Abnormally increased size of the liver. Evidence: TAS. Frequency: Occasional (HP:0040283). (ORPHA:509)
- Lymphadenopathy (HP:0002716): Enlargement (swelling) of a lymph node. Evidence: TAS. Frequency: Occasional (HP:0040283). (ORPHA:509)
- First degree atrioventricular block (HP:0011705): Delay of conduction through the atrioventricular node, which is manifested as prolongation of the PR interval in the electrocardiogram (EKG). All atrial impulses reach the ventricles. Evidence: TAS. Frequency: Occasional (HP:0040283). (ORPHA:509)
- Hepatitis (HP:0012115): Inflammation of the liver. Evidence: TAS. Frequency: Occasional (HP:0040283). (ORPHA:509)
- Cough (HP:0012735): A sudden, audible expulsion of air from the lungs through a partially closed glottis, preceded by inhalation. Evidence: TAS. Frequency: Occasional (HP:0040283). (ORPHA:509)
- Chills (HP:0025143): A sudden sensation of feeling cold. Evidence: TAS. Frequency: Occasional (HP:0040283). (ORPHA:509)
- Pharyngitis (HP:0025439): Inflammation (due to infection or irritation) of the pharynx. Evidence: TAS. Frequency: Occasional (HP:0040283). (ORPHA:509)
- Cellular urinary casts (HP:0031197): A type of urinary cast composed of cells incorporated in a protein matrix. The cells can be those found in the urinary sediment (erythrocytes, leuklocytes, renal tubular epithelial cells). Evidence: TAS. Frequency: Occasional (HP:0040283). (ORPHA:509)
- Pulmonary hemorrhage (HP:0040223): Pulmonary hemorrhage is a bleeding within the lungs. Older children and adults may spit blood or bloody sputum. Neonates, infants and young children usually do not spit up blood. Anemia, pulmonary infiltrates, increasingling bloody return on BAL and the presence of hemosiderin-laden macrophages in broncho-alveolar lavage (BAL) fluid or lung biopsy can diagnose lung bleeding. Alveolar macrophages contain phagocytosed red blood cells and stain positive for hemosiderin, a product of hemoglobin degradation, after about 48-72 hours following pulmonary hemorraghe. Previous or recurrent bleeding can thus be distinguished from fresh events. A differentiation into local or diffuse is of importance. Also differentiate if pulmonary hemorrhage is due to a primary lung disorder or a manifestation of a systemic disease. Evidence: TAS. Frequency: Occasional (HP:0040283). (ORPHA:509)
- Uveitis (HP:0000554): Inflammation of one or all portions of the uveal tract. Evidence: TAS. Frequency: Very rare (HP:0040284). (ORPHA:509)
- Retinal hemorrhage (HP:0000573): Bleeding located within the retina. Retinal hemorrhages range from the smallest dot and blot hemorrhage to massive sub-hyaloid hemorrhage. Evidence: TAS. Frequency: Very rare (HP:0040284). (ORPHA:509)
- Papilledema (HP:0001085): Papilledema refers to edema (swelling) of the optic disc secondary to any factor which increases cerebral spinal fluid pressure. Evidence: TAS. Frequency: Very rare (HP:0040284). (ORPHA:509)
- Pericarditis (HP:0001701): Inflammation of the sac-like covering around the heart (pericardium). Evidence: TAS. Frequency: Very rare (HP:0040284). (ORPHA:509)
- Rhabdomyolysis (HP:0003201): Breakdown of muscle fibers that leads to the release of muscle fiber contents (myoglobin) into the bloodstream. Evidence: TAS. Frequency: Very rare (HP:0040284). (ORPHA:509)
- Arrhythmia (HP:0011675): Any cardiac rhythm other than the normal sinus rhythm. Such a rhythm may be either of sinus or ectopic origin and either regular or irregular. An arrhythmia may be due to a disturbance in impulse formation or conduction or both. Evidence: TAS. Frequency: Very rare (HP:0040284). (ORPHA:509)
- Subconjunctival hemorrhage (HP:0011896): Bleeding beneath the mucous membrane that lines the inner surface of the eyelid. Evidence: TAS. Frequency: Very rare (HP:0040284). (ORPHA:509)
- Chorioretinitis (HP:0012424): An inflammation of the choroid and retina. Evidence: TAS. Frequency: Very rare (HP:0040284). (ORPHA:509)
- Macular cotton wool spot (HP:0030497): Fluffy white patch in the macula, representing localized areas of dense white swelling of the retinal nerve fiber layer. Evidence: TAS. Frequency: Very rare (HP:0040284). (ORPHA:509)
- Optic neuritis (HP:0100653): Inflammation of the optic nerve. Evidence: TAS. Frequency: Very rare (HP:0040284). (ORPHA:509)
These phenotypes are associated with the disease Leptospirosis (ORPHA:509).